Phenotypes associated with the disease congenital disorder of glycosylation, type IIz (OMIM:620201):
- Poor head control (HP:0002421): Difficulty to maintain correct position of the head while standing or sitting. Infant head lag is observed when the head seems to flop around or lags posteriorly behind the trunk. Several articles have maintained that head lag should be absent by age 3 to 4 months. Evidence: PCS. Frequency: 1/1. (PMID:35262690)
- Axial hypotonia (HP:0008936): Muscular hypotonia (abnormally low muscle tone) affecting the musculature of the trunk. Evidence: PCS. Frequency: 1/1. (PMID:35262690)
- Clonus (HP:0002169): A series of rhythmic and involuntary muscle contractions (at a frequency of about 5 to 7 Hz) that occur in response to an abruptly applied and sustained stretch. Evidence: PCS. Frequency: 1/1. (PMID:35262690)
- Developmental regression (HP:0002376): Loss of developmental skills, as manifested by loss of developmental milestones. Evidence: PCS. Frequency: 1/1. (PMID:35262690)
- Seizure (HP:0001250): A seizure is an intermittent abnormality of nervous system physiology characterized by a transient occurrence of signs and/or symptoms due to abnormal excessive or synchronous neuronal activity in the brain. Evidence: PCS. Frequency: 1/1. (PMID:35262690)
- Limb joint contracture (HP:0003121): A contracture (chronic loss of joint motion due to structural changes in muscle, tendons, ligaments, or skin) that prevent normal movement of one or more joints of the limbs. Evidence: PCS. Frequency: 1/1. (PMID:35262690)
- Global developmental delay (HP:0001263): A delay in the achievement of motor or mental milestones in the domains of development of a child, including motor skills, speech and language, cognitive skills, and social and emotional skills. This term should only be used to describe children younger than five years of age. Evidence: PCS. Frequency: 1/1. (PMID:35262690)
- Infantile onset (HP:0003593): Onset of signs or symptoms of disease between 28 days to one year of life. Evidence: PCS. Frequency: 1/1. (PMID:35262690)
- Type II transferrin isoform profile (HP:0012301): Abnormal transferrin isoform profile consistent with a type II congenital disorder of glycosylation. Evidence: PCS. Frequency: 1/1. (PMID:35262690)
- Thin corpus callosum (HP:0033725): An abnormally thin corpus callous, due to atrophy, hypoplasia or agenesis. This term is intended to be used in situations where it is not known if thinning of the corpus callosum (for instance, as visualized by magnetic resonance tomography) is due to abnormal development (e.g. a leukodystrophy) or atrophy following normal development (e.g. neurodegeneration). Evidence: PCS. Frequency: 1/1. (PMID:35262690)
- Diffuse cerebellar atrophy (HP:0100275): Diffuse unlocalised atrophy affecting the cerebellum. Evidence: PCS. Frequency: 1/1. (PMID:35262690)
- Gastrostomy tube feeding in infancy (HP:0011471): Feeding problem necessitating gastrostomy tube feeding. Evidence: PCS. Frequency: 1/1. (PMID:35262690)
- Appendicular spasticity (HP:0034353): A type of spasticity that affects one or more limbs (arms or legs). Evidence: PCS. Frequency: 1/1. (PMID:35262690)
- Autosomal recessive inheritance (HP:0000007): A mode of inheritance that is observed for traits related to a gene encoded on one of the autosomes (i.e., the human chromosomes 1-22) in which a trait manifests in individuals with two pathogenic alleles, either homozygotes (two copies of the same mutant allele) or compound heterozygotes (whereby each copy of a gene has a distinct mutant allele). Evidence: PCS. (PMID:35262690)